Phenotypes associated with the disease spermatogenic failure, X-linked, 5 (OMIM:301099):
- Irregularly shaped sperm tail (HP:0033393): Irregular or changing caliber (diameter) along the tail of the sperm. Evidence: PCS. Frequency: 5/5. (PMID:36796361)
- Reduced progressive sperm motility (HP:0034011): A reduced proportion of sperm that move in a straight line or large circles; alternatively, an increased proportion of sperm that move in tight circles or in some other non-linear fashion. Evidence: PCS. Frequency: 6/6. (PMID:36796361)
- Coiled sperm flagella (HP:0032560): Sperm cells whose flagella are twisted (coiled). Evidence: PCS. Frequency: 5/5. (PMID:36796361)
- Male infertility (HP:0003251). Evidence: PCS. Frequency: 6/6. (PMID:36796361)
- Young adult onset (HP:0011462): Onset of disease at the age of between 16 and 40 years. Evidence: PCS. Frequency: 6/6. (PMID:36796361)
- Reduced sperm motility (HP:0012207): An abnormal reduction in the mobility of ejaculated sperm. Evidence: PCS. Frequency: 6/6. (PMID:36796361)
- X-linked inheritance (HP:0001417): A mode of inheritance that is observed for traits related to a gene encoded on the X chromosome. Evidence: PCS. (PMID:36796361)
- Absent sperm flagella (HP:0032558): Sperm cells lacking flagella. Evidence: PCS. Frequency: 3/5. (PMID:36796361)
- Short sperm flagella (HP:0032559): Sperm cells with abnormally short flagella. Evidence: PCS. Frequency: 5/5. (PMID:36796361)